- Absent eyelashes (HP:0000561): Lack of eyelashes. Evidence: TAS. Frequency: Very frequent (HP:0040281). (ORPHA:363618)
- Hypertension (HP:0000822): The presence of chronic increased pressure in the systemic arterial system. Evidence: TAS. Frequency: Very frequent (HP:0040281). (ORPHA:363618)
- Congestive heart failure (HP:0001635): The presence of an abnormality of cardiac function that is responsible for the failure of the heart to pump blood at a rate that is commensurate with the needs of the tissues or a state in which abnormally elevated filling pressures are required for the heart to do so. Heart failure is frequently related to a defect in myocardial contraction. Evidence: TAS. Frequency: Very frequent (HP:0040281). (ORPHA:363618)
- Aortic valve stenosis (HP:0001650): The presence of a stenosis (narrowing) of the aortic valve. Evidence: TAS. Frequency: Very frequent (HP:0040281). (ORPHA:363618)
- Mitral regurgitation (HP:0001653): An abnormality of the mitral valve characterized by insufficiency or incompetence of the mitral valve resulting in retrograde leaking of blood through the mitral valve upon ventricular contraction. Evidence: TAS. Frequency: Very frequent (HP:0040281). (ORPHA:363618)
- Coronary artery atherosclerosis (HP:0001677): Reduction of the diameter of the coronary arteries as the result of an accumulation of atheromatous plaques within the walls of the coronary arteries, which increases the risk of myocardial ischemia. Evidence: TAS. Frequency: Very frequent (HP:0040281). (ORPHA:363618)
- Ventricular hypertrophy (HP:0001714): Enlargement of the cardiac ventricular muscle tissue with increase in the width of the wall of the ventricle and loss of elasticity. Ventricular hypertrophy is clinically differentiated into left and right ventricular hypertrophy. Evidence: TAS. Frequency: Very frequent (HP:0040281). (ORPHA:363618)
- Emphysema (HP:0002097). Evidence: TAS. Frequency: Very frequent (HP:0040281). (ORPHA:363618)
- Hypertriglyceridemia (HP:0002155): An abnormal increase in the level of triglycerides in the blood. Evidence: TAS. Frequency: Very frequent (HP:0040281). (ORPHA:363618)
- Intracranial hemorrhage (HP:0002170): Hemorrhage occurring within the skull. Evidence: TAS. Frequency: Very frequent (HP:0040281). (ORPHA:363618)
- Premature graying of hair (HP:0002216): Development of gray hair at a younger than normal age. Evidence: TAS. Frequency: Very frequent (HP:0040281). (ORPHA:363618)
- Absent eyebrow (HP:0002223): Absence of the eyebrow. Evidence: TAS. Frequency: Very frequent (HP:0040281). (ORPHA:363618)
- Alopecia universalis (HP:0002289): Loss of all hair on the entire body. Evidence: TAS. Frequency: Very frequent (HP:0040281). (ORPHA:363618)
- Aortic root aneurysm (HP:0002616): An abnormal localized widening (dilatation) of the aortic root. Evidence: TAS. Frequency: Very frequent (HP:0040281). (ORPHA:363618)
- Basal cell carcinoma (HP:0002671): The presence of a basal cell carcinoma of the skin. Evidence: TAS. Frequency: Very frequent (HP:0040281). (ORPHA:363618)
- Hypercholesterolemia (HP:0003124): An increased concentration of cholesterol in the blood. Evidence: TAS. Frequency: Very frequent (HP:0040281). (ORPHA:363618)
- Mitral valve calcification (HP:0004382): Abnormal calcification of the mitral valve. Evidence: TAS. Frequency: Very frequent (HP:0040281). (ORPHA:363618)
- Abnormality of the pulmonary artery (HP:0004414): An abnormality of the pulmonary artery. Evidence: TAS. Frequency: Very frequent (HP:0040281). (ORPHA:363618)
- Squamous cell carcinoma of the skin (HP:0006739): Squamous cell carcinoma of the skin is a malignant tumor of squamous epithelium. Evidence: TAS. Frequency: Very frequent (HP:0040281). (ORPHA:363618)
- Papillary renal cell carcinoma (HP:0006766): The presence of renal cell carcinoma in the renal papilla. Evidence: TAS. Frequency: Very frequent (HP:0040281). (ORPHA:363618)
- Sparse hair (HP:0008070): Reduced density of hairs. Evidence: TAS. Frequency: Very frequent (HP:0040281). (ORPHA:363618)
- Abnormal intrahepatic bile duct morphology (HP:0011040): An abnormality of the intrahepatic bile duct. Evidence: TAS. Frequency: Very frequent (HP:0040281). (ORPHA:363618)
- Aortic atherosclerotic lesion (HP:0012397): The presence of atheromas or atherosclerotic plaques in the aorta. Evidence: TAS. Frequency: Very frequent (HP:0040281). (ORPHA:363618)
- Pulmonary carcinoid tumor (HP:0030445): A malignant neuroendocrine tumor of the lung. According to histopathologic criteria (WHO 2004), carcinoids are divided into four groups i.e. typical and atypical carcinoids, large cell neuroendocrine carcinoma and small cell lung carcinoma. Evidence: TAS. Frequency: Very frequent (HP:0040281). (ORPHA:363618)
- Scleroderma (HP:0100324): A chronic autoimmune phenomenon characterized by fibrosis (or hardening) and vascular alterations of the skin. Evidence: TAS. Frequency: Very frequent (HP:0040281). (ORPHA:363618)
- Lipoatrophy (HP:0100578): Localized loss of fat tissue. Evidence: TAS. Frequency: Very frequent (HP:0040281). (ORPHA:363618)
- Premature skin wrinkling (HP:0100678): The presence of an increased degree of wrinkling (irregular folds and indentations) of the skin as compared with age-related norms. Evidence: TAS. Frequency: Very frequent (HP:0040281). (ORPHA:363618)
These phenotypes are associated with the disease LMNA-related cardiocutaneous progeria syndrome (ORPHA:363618).